Phenotypes associated with the disease nonsyndromic congenital nail disorder 2 (OMIM:149300):
- Concave nail (HP:0001598): The natural longitudinal (posterodistal) convex arch is not present or is inverted. Evidence: IEA. (OMIM:149300)
- Autosomal dominant inheritance (HP:0000006): A mode of inheritance that is observed for traits related to a gene encoded on one of the autosomes (i.e., the human chromosomes 1-22) in which a trait manifests in heterozygotes. In the context of medical genetics, an autosomal dominant disorder is caused when a single copy of the mutant allele is present. Males and females are affected equally, and can both transmit the disorder with a risk of 50% for each child of inheriting the mutant allele. Evidence: IEA. (OMIM:149300)